Phenotypes associated with the disease paternal uniparental disomy of chromosome 14 (OMIM:608149):
- Pulmonary hypoplasia (HP:0002089). Evidence: TAS. Frequency: Occasional (HP:0040283). (OMIM:608149)
- Long philtrum (HP:0000343): Distance between nasal base and midline upper lip vermilion border more than 2 SD above the mean. Alternatively, an apparently increased distance between nasal base and midline upper lip vermilion border. Evidence: TAS. (OMIM:608149)
- Inguinal hernia (HP:0000023): Protrusion of the contents of the abdominal cavity through the inguinal canal. Evidence: TAS. Frequency: Occasional (HP:0040283). (OMIM:608149)
- Anteverted nares (HP:0000463): Anteriorly-facing nostrils viewed with the head in the Frankfurt horizontal and the eyes of the observer level with the eyes of the subject. This gives the appearance of an upturned nose (upturned nasal tip). Evidence: TAS. Frequency: Occasional (HP:0040283). (OMIM:608149)
- Seizure (HP:0001250): A seizure is an intermittent abnormality of nervous system physiology characterized by a transient occurrence of signs and/or symptoms due to abnormal excessive or synchronous neuronal activity in the brain. Evidence: TAS. Frequency: Occasional (HP:0040283). (OMIM:608149)
- Flexion contracture (HP:0001371): A flexion contracture is a bent (flexed) joint that cannot be straightened actively or passively. It is thus a chronic loss of joint motion due to structural changes in muscle, tendons, ligaments, or skin that prevents normal movement of joints. Evidence: TAS. (OMIM:608149)
- Bell-shaped thorax (HP:0001591): The rib cage has the shape of a wide mouthed bell. That is, the superior portion of the rib cage is constricted, followed by a convex region, and the inferior portion of the rib cage expands again to have a large diameter. Evidence: IEA. (OMIM:608149)
- Blepharophimosis (HP:0000581): A fixed reduction in the vertical distance between the upper and lower eyelids with short palpebral fissures. Evidence: TAS. (OMIM:608149)
- Hypotonia (HP:0001252): Hypotonia is an abnormally low muscle tone (the amount of tension or resistance to movement in a muscle). Even when relaxed, muscles have a continuous and passive partial contraction which provides some resistance to passive stretching. Hypotonia thus manifests as diminished resistance to passive stretching. Hypotonia is not the same as muscle weakness, although the two conditions can co-exist. Evidence: TAS. Frequency: Occasional (HP:0040283). (OMIM:608149)
- Hepatomegaly (HP:0002240): Abnormally increased size of the liver. Evidence: TAS. Frequency: Occasional (HP:0040283). (OMIM:608149)
- Short palpebral fissure (HP:0012745): Distance between the medial and lateral canthi is more than 2 SD below the mean for age (objective); or, apparently reduced length of the palpebral fissures. Evidence: TAS. Frequency: Occasional (HP:0040283). (OMIM:608149)
- Generalized hypotonia (HP:0001290): Generalized muscular hypotonia (abnormally low muscle tone). Evidence: TAS. Frequency: Occasional (HP:0040283). (OMIM:608149)
- Frontal hirsutism (HP:0011335): Excessive amount of hair growth on forehead. Evidence: TAS. (OMIM:608149)
- Ventricular septal defect (HP:0001629): A hole between the two bottom chambers (ventricles) of the heart. The defect is centered around the most superior aspect of the ventricular septum. Evidence: TAS. Frequency: Occasional (HP:0040283). (OMIM:608149)
- Microtia (HP:0008551): Underdevelopment of the external ear. Evidence: TAS. (OMIM:608149)
- Long fingers (HP:0100807): The middle finger is more than 2 SD above the mean for newborns 27 to 41 weeks EGA or above the 97th centile for children from birth to 16 years of age AND the five digits retain their normal length proportions relative to each other (i.e., it is not the case that the middle finger is the only lengthened digit), or, Fingers that appear disproportionately long compared to the palm of the hand. Evidence: TAS. Frequency: Occasional (HP:0040283). (OMIM:608149)
- Patent ductus arteriosus (HP:0001643): In utero, the ductus arteriosus (DA) serves to divert ventricular output away from the lungs and toward the placenta by connecting the main pulmonary artery to the descending aorta. A patent ductus arteriosus (PDA) in the first 3 days of life is a physiologic shunt in healthy term and preterm newborn infants, and normally is substantially closed within about 24 hours after bith and completely closed after about three weeks. Failure of physiologcal closure is referred to a persistent or patent ductus arteriosus (PDA). Depending on the degree of left-to-right shunting, PDA can have clinical consequences. Evidence: TAS. Frequency: Occasional (HP:0040283). (OMIM:608149)
- Sporadic (HP:0003745): Cases of the disease in question occur without a previous family history, i.e., as isolated cases without being transmitted from a parent and without other siblings being affected. Evidence: TAS. (OMIM:608149)
- Pulmonic stenosis (HP:0001642): A narrowing of the right ventricular outflow tract that can occur at the pulmonary valve (valvular stenosis), below the pulmonary valve (infundibular stenosis), or above the pulmonary valve (supravalvar stenosis). Evidence: TAS. Frequency: Occasional (HP:0040283). (OMIM:608149)
- Retrognathia (HP:0000278): An abnormality in which the mandible is mislocalised posteriorly. Evidence: TAS. (OMIM:608149)
- Splenomegaly (HP:0001744): Abnormal increased size of the spleen. Evidence: TAS. Frequency: Occasional (HP:0040283). (OMIM:608149)
- Laryngomalacia (HP:0001601): Laryngomalacia is a congenital abnormality of the laryngeal cartilage in which the cartilage is floppy and prolapses over the larynx during inspiration. Evidence: TAS. Frequency: Occasional (HP:0040283). (OMIM:608149)
- Premature birth (HP:0001622): The birth of a baby of less than 37 weeks of gestational age. Evidence: TAS. (OMIM:608149)
- Diastasis recti (HP:0001540): A separation of the rectus abdominis muscle into right and left halves (which are normally joined at the midline at the linea alba). Evidence: TAS. (OMIM:608149)
- Kyphoscoliosis (HP:0002751): An abnormal curvature of the spine in both a coronal (lateral) and sagittal (back-to-front) plane. Evidence: TAS. Frequency: Occasional (HP:0040283). (OMIM:608149)
- Long clavicle (HP:0000890): Increased length of the clavicles. Evidence: TAS. Frequency: Occasional (HP:0040283). (OMIM:608149)
- Polyhydramnios (HP:0001561): The presence of excess amniotic fluid in the uterus during pregnancy. Evidence: TAS. (OMIM:608149)
- Limb undergrowth (HP:0009826): Limb shortening because of underdevelopment of one or more bones of the extremities. Evidence: TAS. (OMIM:608149)
- Coxa valga (HP:0002673): Coxa valga is a deformity of the hip in which the angle between the femoral shaft and the femoral neck is increased compared to age-adjusted values (about 150 degrees in newborns gradually reducing to 120-130 degrees in adults). Evidence: TAS. Frequency: Occasional (HP:0040283). (OMIM:608149)
- Global developmental delay (HP:0001263): A delay in the achievement of motor or mental milestones in the domains of development of a child, including motor skills, speech and language, cognitive skills, and social and emotional skills. This term should only be used to describe children younger than five years of age. Evidence: TAS. Frequency: Occasional (HP:0040283). (OMIM:608149)
- Pulmonary arterial hypertension (HP:0002092): Pulmonary hypertension is defined mean pulmonary artery pressure of 25mmHg or more and pulmonary capillary wedge pressure of 15mmHg or less when measured by right heart catheterisation at rest and in a supine position. Evidence: TAS. Frequency: Occasional (HP:0040283). (OMIM:608149)
- Depressed nasal bridge (HP:0005280): Posterior positioning of the nasal root in relation to the overall facial profile for age. Evidence: TAS. (OMIM:608149)
- Hypoplasia of the maxilla (HP:0000327): Abnormally small dimension of the Maxilla. Usually creating a malocclusion or malalignment between the upper and lower teeth or resulting in a deficient amount of projection of the base of the nose and lower midface region. Evidence: TAS. Frequency: Occasional (HP:0040283). (OMIM:608149)
- Omphalocele (HP:0001539): A midline anterior incomplete closure of the abdominal wall in which there is herniation of the abdominal viscera into the base of the abdominal cord. Evidence: TAS. Frequency: Occasional (HP:0040283). (OMIM:608149)
- Frontal bossing (HP:0002007): Bilateral bulging of the lateral frontal bone prominences with relative sparing of the midline. Evidence: TAS. Frequency: Occasional (HP:0040283). (OMIM:608149)
- Atrial septal defect (HP:0001631): Atrial septal defect (ASD) is a congenital abnormality of the interatrial septum that enables blood flow between the left and right atria via the interatrial septum. Evidence: TAS. Frequency: Occasional (HP:0040283). (OMIM:608149)
- Thin ribs (HP:0000883): Ribs with a reduced diameter. Evidence: TAS. Frequency: Occasional (HP:0040283). (OMIM:608149)
- Micrognathia (HP:0000347): Developmental hypoplasia of the mandible. Evidence: TAS. Frequency: 12/20. (OMIM:608149)
- Autosomal dominant inheritance (HP:0000006): A mode of inheritance that is observed for traits related to a gene encoded on one of the autosomes (i.e., the human chromosomes 1-22) in which a trait manifests in heterozygotes. In the context of medical genetics, an autosomal dominant disorder is caused when a single copy of the mutant allele is present. Males and females are affected equally, and can both transmit the disorder with a risk of 50% for each child of inheriting the mutant allele. Evidence: IEA. (OMIM:608149)